- Cough (HP:0012735): A sudden, audible expulsion of air from the lungs through a partially closed glottis, preceded by inhalation. Evidence: TAS. Frequency: Very frequent (HP:0040281). (ORPHA:1163)
- Positive blood 1,3 beta glucan test (HP:0020153): Beta-1,3-glucan is a major constituent of all of the characterized fungal cell walls, making up between 30-80 percent of the mass of the wall. It is a biomarker of fungal infections such as invasive pulmonary aspergillosis. Evidence: TAS. Frequency: Very frequent (HP:0040281). (ORPHA:1163)
- Decreased total neutrophil count (HP:0001875): Abnormal decrease of absolute number of neutrophils in the blood, per microlitre, compared to a reference range for a given sex and age-group. Evidence: TAS. Frequency: Frequent (HP:0040282). (ORPHA:1163)
- Increased total eosinophil count (HP:0001880): Increased count of eosinophils in the blood. Evidence: TAS. Frequency: Frequent (HP:0040282). (ORPHA:1163)
- Fever (HP:0001945): Body temperature elevated above the normal range. Evidence: TAS. Frequency: Frequent (HP:0040282). (ORPHA:1163)
- Hemoptysis (HP:0002105): Coughing up (expectoration) of blood or blood-streaked sputum from the larynx, trachea, bronchi, or lungs. Evidence: TAS. Frequency: Frequent (HP:0040282). (ORPHA:1163)
- Pulmonary infiltrates (HP:0002113). Evidence: TAS. Frequency: Frequent (HP:0040282). (ORPHA:1163)
- Immunodeficiency (HP:0002721): Failure of the immune system to protect the body adequately from infection, due to the absence or insufficiency of some component process or substance. Evidence: TAS. Frequency: Frequent (HP:0040282). (ORPHA:1163)
- Chronic lung disease (HP:0006528): According to the definitions of the American and British Thoracic Societies, including pulmonary functional tests, X-rays, and CT scans for items such as fibrosis, bronchiectasis, bullae, emphysema, nodular or lymphomatous abnormalities. Evidence: TAS. Frequency: Frequent (HP:0040282). (ORPHA:1163)
- Ground-glass opacification (HP:0025179): On chest radiographs, ground-glass opacity appears as an area of hazy increased lung opacity, usually extensive, within which margins of pulmonary vessels may be indistinct. On CT scans, it appears as hazy increased opacity of lung, with preservation of bronchial and vascular margins. It is caused by partial filling of airspaces, interstitial thickening (due to fluid, cells, and/or fibrosis), partial collapse of alveoli, increased capillary blood volume, or a combination of these, the common factor being the partial displacement of air. Ground-glass opacity is less opaque than consolidation, in which bronchovascular margins are obscured. Evidence: TAS. Frequency: Frequent (HP:0040282). (ORPHA:1163)
- Abnormality on pulmonary function testing (HP:0030878): Any anomaly measure by pulmonary function testing, which includes spirometry, measures of diffusing capacity, and plethysmography. Evidence: TAS. Frequency: Frequent (HP:0040282). (ORPHA:1163)
- Abnormal sputum (HP:0032016): Abnormal appearance of material expectorated (coughed up) from the respiratory system and that is composed of mucus but may contain other substances such as pus, blood, microorganisms, and fibrin. Evidence: TAS. Frequency: Frequent (HP:0040282). (ORPHA:1163)
- Parenchymal consolidation (HP:0032177): Consolidation refers to an exudate or other product of disease that replaces alveolar air, rendering the lung solid (as in infective pneumonia). Evidence: TAS. Frequency: Frequent (HP:0040282). (ORPHA:1163)
- Chest pain (HP:0100749): An unpleasant sensation characterized by physical discomfort (such as pricking, throbbing, or aching) localized to the chest. Evidence: TAS. Frequency: Frequent (HP:0040282). (ORPHA:1163)
- Abnormality of the kidney (HP:0000077): An abnormality of the kidney. Evidence: TAS. Frequency: Occasional (HP:0040283). (ORPHA:1163)
- Sinusitis (HP:0000246): Inflammation of the paranasal sinuses owing to a viral, bacterial, or fungal infection, allergy, or an autoimmune reaction. Evidence: TAS. Frequency: Occasional (HP:0040283). (ORPHA:1163)
- Keratitis (HP:0000491): Inflammation of the cornea. Evidence: TAS. Frequency: Occasional (HP:0040283). (ORPHA:1163)
- Visual impairment (HP:0000505): Visual impairment (or vision impairment) is vision loss (of a person) to such a degree as to qualify as an additional support need through a significant limitation of visual capability resulting from either disease, trauma, or congenital or degenerative conditions that cannot be corrected by conventional means, such as refractive correction, medication, or surgery. Evidence: TAS. Frequency: Occasional (HP:0040283). (ORPHA:1163)
- Dacryocystitis (HP:0000620): Inflammation of the nasolacrimal sac. Evidence: TAS. Frequency: Occasional (HP:0040283). (ORPHA:1163)
- Abnormality of the cardiovascular system (HP:0001626): Any abnormality of the cardiovascular system. Evidence: TAS. Frequency: Occasional (HP:0040283). (ORPHA:1163)
- Nasal congestion (HP:0001742): Reduced ability to pass air through the nasal cavity often leading to mouth breathing. Evidence: TAS. Frequency: Occasional (HP:0040283). (ORPHA:1163)
- Abnormal esophagus morphology (HP:0002031): A structural abnormality of the esophagus. Evidence: TAS. Frequency: Occasional (HP:0040283). (ORPHA:1163)
- Pneumonia (HP:0002090): Inflammation of any part of the lung parenchyma. Evidence: TAS. Frequency: Occasional (HP:0040283). (ORPHA:1163)
- Dyspnea (HP:0002094): Difficult or labored breathing. Dyspnea is a subjective feeling only the patient can rate, e.g., on a Borg scale. Evidence: TAS. Frequency: Occasional (HP:0040283). (ORPHA:1163)
- Asthma (HP:0002099): Asthma is characterized by increased responsiveness of the tracheobronchial tree to multiple stimuli, leading to narrowing of the air passages with resultant dyspnea, cough, and wheezing. Evidence: TAS. Frequency: Occasional (HP:0040283). (ORPHA:1163)
- Pleuritis (HP:0002102): Inflammation of the pleura. Evidence: TAS. Frequency: Occasional (HP:0040283). (ORPHA:1163)
- Pulmonary fibrosis (HP:0002206): Replacement of normal lung tissues by fibroblasts and collagen. Evidence: TAS. Frequency: Occasional (HP:0040283). (ORPHA:1163)
- Diffuse reticular or finely nodular infiltrations (HP:0002207). Evidence: TAS. Frequency: Occasional (HP:0040283). (ORPHA:1163)
- Headache (HP:0002315): Cephalgia, or pain sensed in various parts of the head, not confined to the area of distribution of any nerve. Evidence: TAS. Frequency: Occasional (HP:0040283). (ORPHA:1163)
- Increased circulating IgE concentration (HP:0003212): An abnormally increased overall level of immunoglobulin E in blood. Evidence: TAS. Frequency: Occasional (HP:0040283). (ORPHA:1163)
- Hematological neoplasm (HP:0004377): Neoplasms located in the blood and blood-forming tissue (the bone marrow and lymphatic tissue). Evidence: TAS. Frequency: Occasional (HP:0040283). (ORPHA:1163)
- Chronic pulmonary obstruction (HP:0006510): An anomaly that is characterized progressive airflow obstruction that is only partly reversible, inflammation in the airways, and systemic effects or comorbities. Evidence: TAS. Frequency: Occasional (HP:0040283). (ORPHA:1163)
- Hypersensitivity pneumonitis (HP:0006516): Hypersensitivity pneumonitis involves inhalation of an antigen. This leads to an exaggerated immune response and a following inflammation of the alveoli within the lungs. The main feature of chronic hypersensitivity pneumonitis on lung biopsies is expansion of the interstitium by lymphocytes accompanied by an occasional multinucleated giant cell or loose granuloma. After exposure to the provoking antigen, following symptoms can be seen: fever, chills, malaise, cough, hemoptysis, chest tightness, dyspnea, rash, swelling and headache and can be completely reversible, based on the duration of the illness, categorized as acute (HP:0011009), subacute (HP:0011011), and chronic (HP:0011010). Evidence: TAS. Frequency: Occasional (HP:0040283). (ORPHA:1163)
- Localized skin lesion (HP:0011355): A lesion of the skin that is located in a specific region rather than being generalized. Evidence: TAS. Frequency: Occasional (HP:0040283). (ORPHA:1163)
- Hepatitis (HP:0012115): Inflammation of the liver. Evidence: TAS. Frequency: Occasional (HP:0040283). (ORPHA:1163)
- Invasive pulmonary aspergillosis (HP:0020103): Infection of the lungs with aspergillus. In the respiratory mucosa, the spores may germinate into hyphae, which in turn can invade the mucosa leading to invasive pulmonary aspergillosis. Evidence: TAS. Frequency: Occasional (HP:0040283). (ORPHA:1163)
- Rhinorrhea (HP:0031417): Increased discharge of mucus from the nose. Evidence: TAS. Frequency: Occasional (HP:0040283). (ORPHA:1163)
- Immunologic hypersensitivity (HP:0100326): Immunological states where the immune system produces harmful responses upon reexposure to sensitizing antigens. Evidence: TAS. Frequency: Occasional (HP:0040283). (ORPHA:1163)
- Ocular pain (HP:0200026): An unpleasant sensation characterized by physical discomfort (such as pricking, throbbing, or aching) localized to the eye. Evidence: TAS. Frequency: Occasional (HP:0040283). (ORPHA:1163)
- Periorbital fullness (HP:0000629): Increase in periorbital soft tissue. Evidence: TAS. Frequency: Very rare (HP:0040284). (ORPHA:1163)
- Abnormal rib morphology (HP:0000772): An anomaly of the rib. Evidence: TAS. Frequency: Very rare (HP:0040284). (ORPHA:1163)
- Abnormality of the vertebral column (HP:0000925): Any abnormality of the vertebral column. Evidence: TAS. Frequency: Very rare (HP:0040284). (ORPHA:1163)
- Seizure (HP:0001250): A seizure is an intermittent abnormality of nervous system physiology characterized by a transient occurrence of signs and/or symptoms due to abnormal excessive or synchronous neuronal activity in the brain. Evidence: TAS. Frequency: Very rare (HP:0040284). (ORPHA:1163)
- Meningitis (HP:0001287): Inflammation of the meninges. Evidence: TAS. Frequency: Very rare (HP:0040284). (ORPHA:1163)
- Stroke (HP:0001297): Sudden impairment of blood flow to a part of the brain due to occlusion or rupture of an artery to the brain. Evidence: TAS. Frequency: Very rare (HP:0040284). (ORPHA:1163)
- Bronchiectasis (HP:0002110): Persistent abnormal dilatation of the bronchi owing to localized and irreversible destruction and widening of the large airways. Evidence: TAS. Frequency: Very rare (HP:0040284). (ORPHA:1163)
- Intracranial hemorrhage (HP:0002170): Hemorrhage occurring within the skull. Evidence: TAS. Frequency: Very rare (HP:0040284). (ORPHA:1163)
- Pleural effusion (HP:0002202): The presence of an excessive amount of fluid in the pleural cavity. Evidence: TAS. Frequency: Very rare (HP:0040284). (ORPHA:1163)
- Infectious encephalitis (HP:0002383): A disorder of the brain caused by an infectious agent that presents with fever, headache, and an altered level of consciousness. There may also be focal or multifocal neurologic deficits, and focal or generalized seizure activity. Evidence: TAS. Frequency: Very rare (HP:0040284). (ORPHA:1163)
- Abnormal skull base morphology (HP:0002693): An abnormality of the base of the skull, which forms the floor of the cranial cavity and separates the brain from other facial structures. The skull base is made up of five bones: the ethmoid, sphenoid, occipital, paired frontal, and paired parietal bones, and is subdivided into 3 regions: the anterior, middle, and posterior cranial fossae. The petro-occipital fissure subdivides the middle cranial fossa into 1 central component and 2 lateral components. Evidence: TAS. Frequency: Very rare (HP:0040284). (ORPHA:1163)
- Osteomyelitis (HP:0002754): Osteomyelitis is an inflammatory process accompanied by bone destruction and caused by an infecting microorganism. Evidence: TAS. Frequency: Very rare (HP:0040284). (ORPHA:1163)
- Functional motor deficit (HP:0004302). Evidence: TAS. Frequency: Very rare (HP:0040284). (ORPHA:1163)
- Abnormal tracheobronchial morphology (HP:0005607). Evidence: TAS. Frequency: Very rare (HP:0040284). (ORPHA:1163)
- Abnormal long bone morphology (HP:0011314): An abnormality of size or shape of the long bones. Evidence: TAS. Frequency: Very rare (HP:0040284). (ORPHA:1163)
- Unusual CNS infection (HP:0011450): Increased susceptibility to infections of the central nervous system, as manifested by recurrent, severe, or invasive infections involving the brain, meninges, or spinal cord. This can include infections caused by opportunistic or atypical pathogens, or common pathogens presenting with unusual severity or in anatomical locations. Evidence: TAS. Frequency: Very rare (HP:0040284). (ORPHA:1163)
- Vitritis (HP:0011531): Inflammation of the vitreous body, characterized by the presence of inflammatory cells and protein exudate in the vitreous cavity. Evidence: TAS. Frequency: Very rare (HP:0040284). (ORPHA:1163)
These phenotypes are associated with the disease Aspergillosis (ORPHA:1163).